- Hypersarcosinemia (HP:0010896): An elevated plasma concentration of sarcosine. Evidence: TAS. Frequency: Obligate (HP:0040280). (ORPHA:3129)
- Hypersarcosinuria (HP:0010897): An elevated urinary concentration of sarcosine. Evidence: TAS. Frequency: Very frequent (HP:0040281). (ORPHA:3129)
- Strabismus (HP:0000486): A misalignment of the eyes so that the visual axes deviate from bifoveal fixation. The classification of strabismus may be based on a number of features including the relative position of the eyes, whether the deviation is latent or manifest, intermittent or constant, concomitant or otherwise and according to the age of onset and the relevance of any associated refractive error. Evidence: TAS. Frequency: Occasional (HP:0040283). (ORPHA:3129)
- Optic atrophy (HP:0000648): Atrophy of the optic nerve. Optic atrophy results from the death of the retinal ganglion cell axons that comprise the optic nerve and manifesting as a pale optic nerve on fundoscopy. Evidence: TAS. Frequency: Occasional (HP:0040283). (ORPHA:3129)
- Emotional lability (HP:0000712): Unstable emotional experiences and frequent mood changes; emotions that are easily aroused, intense, and/or disproportionate to events and circumstances. Evidence: TAS. Frequency: Occasional (HP:0040283). (ORPHA:3129)
- Ataxia (HP:0001251): Ataxia refers to impaired coordination of voluntary muscle movement. Cerebellar ataxia refers to ataxia due to dysfunction of the cerebellum. This causes a variety of elementary neurological deficits including asynergy (lack of coordination between muscles, limbs and joints), dysmetria (lack of ability to judge distances that can lead to under- or overshoot in grasping movements), and dysdiadochokinesia (inability to perform rapid movements requiring antagonizing muscle groups to be switched on and off repeatedly). Evidence: TAS. Frequency: Occasional (HP:0040283). (ORPHA:3129)
- Mild intellectual disability (HP:0001256): Mild intellectual disability (ID) is defined as a type of ID characterized by mildly sub-average adaptive functioning and intellectual functioning, with an intelligence quotient (IQ) the range of 50-69. Evidence: TAS. Frequency: Occasional (HP:0040283). (ORPHA:3129)
- Global developmental delay (HP:0001263): A delay in the achievement of motor or mental milestones in the domains of development of a child, including motor skills, speech and language, cognitive skills, and social and emotional skills. This term should only be used to describe children younger than five years of age. Evidence: TAS. Frequency: Occasional (HP:0040283). (ORPHA:3129)
- Motor delay (HP:0001270): A type of Developmental delay characterized by a delay in acquiring motor skills. Evidence: TAS. Frequency: Occasional (HP:0040283). (ORPHA:3129)
- Hypertrophic cardiomyopathy (HP:0001639): Hypertrophic cardiomyopathy (HCM) is defined by the presence of increased ventricular wall thickness or mass in the absence of loading conditions (hypertension, valve disease) sufficient to cause the observed abnormality. Evidence: TAS. Frequency: Occasional (HP:0040283). (ORPHA:3129)
- Pulmonic stenosis (HP:0001642): A narrowing of the right ventricular outflow tract that can occur at the pulmonary valve (valvular stenosis), below the pulmonary valve (infundibular stenosis), or above the pulmonary valve (supravalvar stenosis). Evidence: TAS. Frequency: Occasional (HP:0040283). (ORPHA:3129)
- Bilateral tonic-clonic seizure (HP:0002069): A bilateral tonic-clonic seizure is a seizure defined by a tonic (bilateral increased tone, lasting seconds to minutes) and then a clonic (bilateral sustained rhythmic jerking) phase. Evidence: TAS. Frequency: Occasional (HP:0040283). (ORPHA:3129)
- Tetraparesis (HP:0002273): Weakness of all four limbs. Evidence: TAS. Frequency: Occasional (HP:0040283). (ORPHA:3129)
- Sleep disturbance (HP:0002360): An abnormal pattern in the quality, quantity, or characteristics of sleep. Evidence: TAS. Frequency: Occasional (HP:0040283). (ORPHA:3129)
- Loss of speech (HP:0002371). Evidence: TAS. Frequency: Occasional (HP:0040283). (ORPHA:3129)
- Poor speech (HP:0002465). Evidence: TAS. Frequency: Occasional (HP:0040283). (ORPHA:3129)
- Congenital blindness (HP:0007875): Blindness with onset at birth. Evidence: TAS. Frequency: Occasional (HP:0040283). (ORPHA:3129)
- Infantile sensorineural hearing impairment (HP:0008610): A form of sensorineural hearing impairment with infantile onset. Evidence: TAS. Frequency: Occasional (HP:0040283). (ORPHA:3129)
- Floppy infant (HP:0008947): Floppiness/hypotonia is defined as reduced resistance to passive movement of joints. Physical examination of floppy/hypotonic infants shows head lag, lack of shoulder and elbow muscle contraction on traction response, inability to tighten the shoulder girdle muscles (or slipping through) when held under the axillae, scarf sign (when the arm is pulled to the opposite side, the arm wraps around the neck with the elbow crossing midline), hyperdorsiflexion of the feet, easy apposition of the thumb against the forearm, feet touching the cheek with ease and without discomfort, frog leg position, and inverted U sign on ventral suspension (head, arms, and legs hanging down without elbow or knee flexion and the trunk rounded in a dome shape). Evidence: TAS. Frequency: Occasional (HP:0040283). (ORPHA:3129)
- Dyslexia (HP:0010522): A learning disorder characterized primarily by difficulties in learning to read and spell. Dyslectic children also exhibit a tendency to read words from right to left and to confuse letters such as b and d whose orientation is important for their identification. Children with dyslexia appear to be impaired in phonemic skills (the ability to associate visual symbols with the sounds they represent). Evidence: TAS. Frequency: Occasional (HP:0040283). (ORPHA:3129)
- Peroneal muscle weakness (HP:0011727): Weakness of the peroneal muscles. Evidence: TAS. Frequency: Occasional (HP:0040283). (ORPHA:3129)
- Abnormality of movement (HP:0100022): An abnormality of movement with a neurological basis characterized by changes in coordination and speed of voluntary movements. Evidence: TAS. Frequency: Occasional (HP:0040283). (ORPHA:3129)
These phenotypes are associated with the disease Sarcosinemia (ORPHA:3129).